- Punctate corneal epithelial erosions (HP:0000584). Evidence: IEA. (OMIM:103420)
- Photophobia (HP:0000613): Excessive sensitivity to light with the sensation of discomfort or pain in the eyes due to exposure to bright light. Evidence: IEA. (OMIM:103420)
- Lacrimal gland hypoplasia (HP:0007732): Underdevelopment of the lacrimal gland. Evidence: IEA. (OMIM:103420)
- Lacrimal punctal atresia (HP:0007820): Congenital absence or closure of the opening of the lacrimal punctum. Evidence: IEA. (OMIM:103420)
- Autosomal dominant inheritance (HP:0000006): A mode of inheritance that is observed for traits related to a gene encoded on one of the autosomes (i.e., the human chromosomes 1-22) in which a trait manifests in heterozygotes. In the context of medical genetics, an autosomal dominant disorder is caused when a single copy of the mutant allele is present. Males and females are affected equally, and can both transmit the disorder with a risk of 50% for each child of inheriting the mutant allele. Evidence: IEA. (OMIM:103420)
- Decreased lacrimation (HP:0000633): Abnormally decreased lacrimation, that is, reduced tear production. Evidence: PCS. (OMIM:103420)
- Alacrima (HP:0000522): Absence of tear secretion. Evidence: PCS. (OMIM:103420)
These phenotypes are associated with the disease alacrima, congenital, autosomal dominant (OMIM:103420).